Phenotypes associated with the disease hyper-IgM syndrome type 5 (OMIM:608106):
- Increased circulating IgM concentration (HP:0003496): An abnormally increased level of immunoglobulin M in blood. Evidence: PCS. Frequency: 3/3. (PMID:12958596)
- Recurrent upper and lower respiratory tract infections (HP:0200117): Increased susceptibility to upper and lower respiratory tract infections as manifested by recurrent episodes of upper and lower respiratory tract infections. Evidence: PCS. Frequency: 1/3. (PMID:12958596)
- Childhood onset (HP:0011463): Onset of disease at the age of between 1 and 5 years. Evidence: PCS. Frequency: 2/2. (PMID:12958596)
- Epididymitis (HP:0000031): The presence of inflammation of the epididymis. Evidence: PCS. Frequency: 1/3. (PMID:12958596)
- Impaired Ig class switch recombination (HP:0002959): An impairment of the class-switch recombination process that normally leads B lymphocytes to produce IgG, IgA, or IgE. Evidence: PCS. Frequency: 3/3. (PMID:12958596)
- Recurrent bacterial infections (HP:0002718): Increased susceptibility to bacterial infections as manifested by recurrent episodes of bacterial infection. Evidence: PCS. Frequency: 3/3. (PMID:12958596)
- Autosomal recessive inheritance (HP:0000007): A mode of inheritance that is observed for traits related to a gene encoded on one of the autosomes (i.e., the human chromosomes 1-22) in which a trait manifests in individuals with two pathogenic alleles, either homozygotes (two copies of the same mutant allele) or compound heterozygotes (whereby each copy of a gene has a distinct mutant allele). Evidence: PCS. (PMID:12958596)
- Lymphadenopathy (HP:0002716): Enlargement (swelling) of a lymph node. Evidence: PCS. Frequency: 3/3. (PMID:12958596)
- Decreased circulating IgA concentration (HP:0002720): Decreased levels of immunoglobulin A (IgA). Evidence: PCS. Frequency: 3/3. (PMID:12958596)
- Immunodeficiency (HP:0002721): Failure of the immune system to protect the body adequately from infection, due to the absence or insufficiency of some component process or substance. Evidence: PCS. (PMID:12958596)
- Decreased circulating IgG concentration (HP:0004315): An abnormally decreased level of immunoglobulin G (IgG) in blood. Evidence: PCS. Frequency: 3/3. (PMID:12958596)